- Facial palsy (HP:0010628): Facial nerve palsy is a dysfunction of cranial nerve VII (the facial nerve) that results in inability to control facial muscles on the affected side with weakness of the muscles of facial expression and eye closure. This can either be present in unilateral or bilateral form. Evidence: IEA. (OMIM:110050)
- Mask-like facies (HP:0000298): A lack of facial expression often with staring eyes and a slightly open mouth. Evidence: IEA. (OMIM:110050)
- Telecanthus (HP:0000506): Distance between the inner canthi more than two standard deviations above the mean (objective); or, apparently increased distance between the inner canthi. Evidence: IEA. (OMIM:110050)
- Autosomal dominant inheritance (HP:0000006): A mode of inheritance that is observed for traits related to a gene encoded on one of the autosomes (i.e., the human chromosomes 1-22) in which a trait manifests in heterozygotes. In the context of medical genetics, an autosomal dominant disorder is caused when a single copy of the mutant allele is present. Males and females are affected equally, and can both transmit the disorder with a risk of 50% for each child of inheriting the mutant allele. Evidence: IEA. (OMIM:110050)
- Intellectual disability (HP:0001249): The term intellectual disability or intellectual developmental disorder is used to describe significantly sub-average intellectual and adaptive functioning based on clinical assessment and as measured by individually administered, appropriately normed, standardized and validated tests of intellectual functioning and adaptive behavior, with onset during the developmental period from infancy through adolescence. Evidence: IEA. (OMIM:110050)
- Torsion dystonia (HP:0001304): Sustained involuntary muscle contractions that produce twisting and repetitive movements of the body. Evidence: IEA. (OMIM:110050)
These phenotypes are associated with the disease blepharonasofacial malformation syndrome (OMIM:110050).